- Hypoxemia (HP:0012418): An abnormally low level of blood oxygen. Evidence: TAS. Frequency: Obligate (HP:0040280). (ORPHA:330012)
- Pulmonary edema (HP:0100598): Fluid accumulation in the lungs. Evidence: TAS. Frequency: Obligate (HP:0040280). (ORPHA:330012)
- Dyspnea (HP:0002094): Difficult or labored breathing. Dyspnea is a subjective feeling only the patient can rate, e.g., on a Borg scale. Evidence: TAS. Frequency: Very frequent (HP:0040281). (ORPHA:330012)
- Cyanosis (HP:0000961): Bluish discoloration of the skin and mucosa due to poor circulation or inadequate oxygenation of arterial or capillary blood. Evidence: TAS. Frequency: Frequent (HP:0040282). (ORPHA:330012)
- Tachycardia (HP:0001649): A rapid heartrate that exceeds the range of the normal resting heartrate for age. Evidence: TAS. Frequency: Frequent (HP:0040282). (ORPHA:330012)
- Increased total leukocyte count (HP:0001974): An abnormal increase in the number of leukocytes in the blood. Evidence: TAS. Frequency: Frequent (HP:0040282). (ORPHA:330012)
- Nausea and vomiting (HP:0002017): Nausea is a commonly encountered symptom that has been defined as an unpleasant painless subjective feeling that one will imminently vomit. Vomiting has been defined as the forceful expulsion of the contents of the stomach, duodenum, or jejunum through the oral cavity. While nausea and vomiting are often thought to exist on a temporal continuum, this is not always the case. There are situations when severe nausea may be present without emesis and less frequently, when emesis may be present without preceding nausea. Evidence: TAS. Frequency: Frequent (HP:0040282). (ORPHA:330012)
- Anorexia (HP:0002039): Lack of desire to eat (loss of appetite). Evidence: TAS. Frequency: Frequent (HP:0040282). (ORPHA:330012)
- Headache (HP:0002315): Cephalgia, or pain sensed in various parts of the head, not confined to the area of distribution of any nerve. Evidence: TAS. Frequency: Frequent (HP:0040282). (ORPHA:330012)
- Sleep disturbance (HP:0002360): An abnormal pattern in the quality, quantity, or characteristics of sleep. Evidence: TAS. Frequency: Frequent (HP:0040282). (ORPHA:330012)
- Exercise intolerance (HP:0003546): A functional motor deficit where individuals whose responses to the challenges of exercise fail to achieve levels considered normal for their age and gender. Evidence: TAS. Frequency: Frequent (HP:0040282). (ORPHA:330012)
- Cough (HP:0012735): A sudden, audible expulsion of air from the lungs through a partially closed glottis, preceded by inhalation. Evidence: TAS. Frequency: Frequent (HP:0040282). (ORPHA:330012)
- Crackles (HP:0030830): Crackles are discontinuous, explosive, and nonmusical adventitious lung sounds normally heard in inspiration and sometimes during expiration. Crackles are usually classified as fine and coarse crackles based on their duration, loudness, pitch, timing in the respiratory cycle, and relationship to coughing and changing body position. Evidence: TAS. Frequency: Frequent (HP:0040282). (ORPHA:330012)
- Pulmonary opacity (HP:0031457): Opacity refers to any area that preferentially attenuates the x-ray beam and therefore appears more opaque than the surrounding area. It is a nonspecific term that does not indicate the size or pathologic nature of the abnormality. Evidence: TAS. Frequency: Frequent (HP:0040282). (ORPHA:330012)
- Fever (HP:0001945): Body temperature elevated above the normal range. Evidence: TAS. Frequency: Occasional (HP:0040283). (ORPHA:330012)
- Vertigo (HP:0002321): An abnormal sensation of spinning while the body is actually stationary. Evidence: TAS. Frequency: Occasional (HP:0040283). (ORPHA:330012)
- Tachypnea (HP:0002789): Very rapid breathing. Evidence: TAS. Frequency: Occasional (HP:0040283). (ORPHA:330012)
- Orthopnea (HP:0012764): A sensation of breathlessness in the recumbent position, relieved by sitting or standing. Evidence: TAS. Frequency: Occasional (HP:0040283). (ORPHA:330012)
- Abnormal sputum (HP:0032016): Abnormal appearance of material expectorated (coughed up) from the respiratory system and that is composed of mucus but may contain other substances such as pus, blood, microorganisms, and fibrin. Evidence: TAS. Frequency: Occasional (HP:0040283). (ORPHA:330012)
- Chest pain (HP:0100749): An unpleasant sensation characterized by physical discomfort (such as pricking, throbbing, or aching) localized to the chest. Evidence: TAS. Frequency: Occasional (HP:0040283). (ORPHA:330012)
- Hemoptysis (HP:0002105): Coughing up (expectoration) of blood or blood-streaked sputum from the larynx, trachea, bronchi, or lungs. Evidence: TAS. Frequency: Very rare (HP:0040284). (ORPHA:330012)
These phenotypes are associated with the disease High altitude pulmonary edema (ORPHA:330012).